Phenotypes associated with the disease dermoid cyst of ovary (OMIM:166950):
- Autosomal dominant inheritance (HP:0000006): A mode of inheritance that is observed for traits related to a gene encoded on one of the autosomes (i.e., the human chromosomes 1-22) in which a trait manifests in heterozygotes. In the context of medical genetics, an autosomal dominant disorder is caused when a single copy of the mutant allele is present. Males and females are affected equally, and can both transmit the disorder with a risk of 50% for each child of inheriting the mutant allele. Evidence: TAS. (OMIM:166950)
- Ovarian teratoma (HP:0012226): The presence of a teratoma in the ovary. Evidence: TAS. (OMIM:166950)